- Elevated circulating alpha-fetoprotein concentration (HP:0006254): The concentration of alpha-fetoprotein in the blood circulation is above the upper limit of normal. Evidence: PCS. (PMID:14699509)
- Autosomal dominant inheritance (HP:0000006): A mode of inheritance that is observed for traits related to a gene encoded on one of the autosomes (i.e., the human chromosomes 1-22) in which a trait manifests in heterozygotes. In the context of medical genetics, an autosomal dominant disorder is caused when a single copy of the mutant allele is present. Males and females are affected equally, and can both transmit the disorder with a risk of 50% for each child of inheriting the mutant allele. Evidence: PCS. (PMID:14699509)
These phenotypes are associated with the disease Alpha-Fetoprotein, hereditary persistence of (OMIM:615970).